- Hypertension (HP:0000822): The presence of chronic increased pressure in the systemic arterial system. Evidence: TAS. Frequency: Frequent (HP:0040282). (ORPHA:563)
- Congestive heart failure (HP:0001635): The presence of an abnormality of cardiac function that is responsible for the failure of the heart to pump blood at a rate that is commensurate with the needs of the tissues or a state in which abnormally elevated filling pressures are required for the heart to do so. Heart failure is frequently related to a defect in myocardial contraction. Evidence: TAS. Frequency: Frequent (HP:0040282). (ORPHA:563)
- Dilated cardiomyopathy (HP:0001644): Dilated cardiomyopathy (DCM) is defined by the presence of left ventricular dilatation and left ventricular systolic dysfunction in the absence of abnormal loading conditions (hypertension, valve disease) or coronary artery disease sufficient to cause global systolic impairment. Right ventricular dilation and dysfunction may be present but are not necessary for the diagnosis. Evidence: TAS. Frequency: Frequent (HP:0040282). (ORPHA:563)
- Tachycardia (HP:0001649): A rapid heartrate that exceeds the range of the normal resting heartrate for age. Evidence: TAS. Frequency: Frequent (HP:0040282). (ORPHA:563)
- Left ventricular hypertrophy (HP:0001712): Enlargement or increased size of the heart left ventricle. Evidence: TAS. Frequency: Frequent (HP:0040282). (ORPHA:563)
- Palpitations (HP:0001962): A sensation that the heart is pounding or racing, which is a non-specific sign but may be a manifestation of arrhythmia. Evidence: TAS. Frequency: Frequent (HP:0040282). (ORPHA:563)
- Dyspnea (HP:0002094): Difficult or labored breathing. Dyspnea is a subjective feeling only the patient can rate, e.g., on a Borg scale. Evidence: TAS. Frequency: Frequent (HP:0040282). (ORPHA:563)
- Exertional dyspnea (HP:0002875): Perceived difficulty to breathe that occurs with exercise or exertion and improves with rest. Evidence: TAS. Frequency: Frequent (HP:0040282). (ORPHA:563)
- Abnormal T-wave (HP:0005135): An abnormality of the T wave on the electrocardiogram, which mainly represents the repolarization of the ventricles. Evidence: TAS. Frequency: Frequent (HP:0040282). (ORPHA:563)
- Pedal edema (HP:0010741): An abnormal accumulation of excess fluid in the lower extremity resulting in swelling of the feet and extending upward to the lower leg. Evidence: TAS. Frequency: Frequent (HP:0040282). (ORPHA:563)
- Sinus tachycardia (HP:0011703): Heart rate of greater than 100 beats per minute. Evidence: TAS. Frequency: Frequent (HP:0040282). (ORPHA:563)
- Fatigue (HP:0012378): A subjective feeling of tiredness characterized by a lack of energy and motivation. Evidence: TAS. Frequency: Frequent (HP:0040282). (ORPHA:563)
- Reduced left ventricular ejection fraction (HP:0012664): A diminution of the volumetric fraction of blood pumped out of the ventricle with each cardiac cycle. Evidence: TAS. Frequency: Frequent (HP:0040282). (ORPHA:563)
- Orthopnea (HP:0012764): A sensation of breathlessness in the recumbent position, relieved by sitting or standing. Evidence: TAS. Frequency: Frequent (HP:0040282). (ORPHA:563)
- Left ventricular systolic dysfunction (HP:0025169): Abnormality of left ventricular contraction, often defined operationally as an ejection fraction of less than 40 percent. Evidence: TAS. Frequency: Frequent (HP:0040282). (ORPHA:563)
- Elevated jugular venous pressure (HP:0030848): Increased jugular venous pressure. Evidence: TAS. Frequency: Frequent (HP:0040282). (ORPHA:563)
- Mitral regurgitation (HP:0001653): An abnormality of the mitral valve characterized by insufficiency or incompetence of the mitral valve resulting in retrograde leaking of blood through the mitral valve upon ventricular contraction. Evidence: TAS. Frequency: Occasional (HP:0040283). (ORPHA:563)
- Right ventricular failure (HP:0001708): Reduced ability of the right ventricle to perform its function (to receive blood from the right atrium and to eject blood into the pulmonary artery), often leading to pitting peripheral edema, ascites, and hepatomegaly. Evidence: TAS. Frequency: Occasional (HP:0040283). (ORPHA:563)
- Thromboembolism (HP:0001907): The formation of a blood clot inside a blood vessel that subsequently travels through the blood stream from the site where it formed to another location in the body, generally leading to vascular occlusion at the distant site. Evidence: TAS. Frequency: Occasional (HP:0040283). (ORPHA:563)
- Pulmonary arterial hypertension (HP:0002092): Pulmonary hypertension is defined mean pulmonary artery pressure of 25mmHg or more and pulmonary capillary wedge pressure of 15mmHg or less when measured by right heart catheterisation at rest and in a supine position. Evidence: TAS. Frequency: Occasional (HP:0040283). (ORPHA:563)
- Ventricular tachycardia (HP:0004756): A tachycardia originating in the ventricles characterized by rapid heart rate (over 100 beats per minute) and broad QRS complexes (over 120 ms). Evidence: TAS. Frequency: Occasional (HP:0040283). (ORPHA:563)
- Abnormal cardiac atrium morphology (HP:0005120): Any structural abnormality of a cardiac atrium. Evidence: TAS. Frequency: Occasional (HP:0040283). (ORPHA:563)
- Right ventricular dilatation (HP:0005133): Enlargement of the chamber of the right ventricle, which can be defined echocardiographically as a right ventricular to left ventricular ratio greater than 1:1. Evidence: TAS. Frequency: Occasional (HP:0040283). (ORPHA:563)
- Abnormal atrioventricular valve morphology (HP:0006705): An abnormality of an atrioventricular valve. Evidence: TAS. Frequency: Occasional (HP:0040283). (ORPHA:563)
- Peripheral edema (HP:0012398): An abnormal accumulation of interstitial fluid in the soft tissues of the limbs. Evidence: TAS. Frequency: Occasional (HP:0040283). (ORPHA:563)
- Paroxysmal dyspnea (HP:0012763): A sudden attack of dyspnea that occurs while the affected person is at rest. Evidence: TAS. Frequency: Occasional (HP:0040283). (ORPHA:563)
- Myocarditis (HP:0012819): Inflammation of the myocardium. Evidence: TAS. Frequency: Occasional (HP:0040283). (ORPHA:563)
- Heart murmur (HP:0030148): An extra or unusual sound heard during a heartbeat caused vibrations resulting from the flow of blood through the heart. Evidence: TAS. Frequency: Occasional (HP:0040283). (ORPHA:563)
- Increased circulating interferon-gamma concentration (HP:0030356): An elevation in the concentration of interferon gamma measured in the blood circulation. Evidence: TAS. Frequency: Occasional (HP:0040283). (ORPHA:563)
- Crackles (HP:0030830): Crackles are discontinuous, explosive, and nonmusical adventitious lung sounds normally heard in inspiration and sometimes during expiration. Crackles are usually classified as fine and coarse crackles based on their duration, loudness, pitch, timing in the respiratory cycle, and relationship to coughing and changing body position. Evidence: TAS. Frequency: Occasional (HP:0040283). (ORPHA:563)
- Left atrial enlargement (HP:0031295): Increase in size of the left atrium. Evidence: TAS. Frequency: Occasional (HP:0040283). (ORPHA:563)
- Preeclampsia (HP:0100602): Pregnancy-induced hypertension in association with significant amounts of protein in the urine. Evidence: TAS. Frequency: Occasional (HP:0040283). (ORPHA:563)
- Toxemia of pregnancy (HP:0100603): Pregnancy-induced toxic reactions of the mother that can be as harmless as slight Maternal hypertension or as life threatening as Eclampsia. Evidence: TAS. Frequency: Occasional (HP:0040283). (ORPHA:563)
- Chest pain (HP:0100749): An unpleasant sensation characterized by physical discomfort (such as pricking, throbbing, or aching) localized to the chest. Evidence: TAS. Frequency: Occasional (HP:0040283). (ORPHA:563)
- Diabetes mellitus (HP:0000819): A group of abnormalities characterized by hyperglycemia and glucose intolerance. Evidence: TAS. Frequency: Very rare (HP:0040284). (ORPHA:563)
- Obesity (HP:0001513): Accumulation of substantial excess body fat. Evidence: TAS. Frequency: Very rare (HP:0040284). (ORPHA:563)
- Anemia (HP:0001903): A reduction in erythrocytes volume or hemoglobin concentration. Evidence: TAS. Frequency: Very rare (HP:0040284). (ORPHA:563)
- Abdominal pain (HP:0002027): An unpleasant sensation characterized by physical discomfort (such as pricking, throbbing, or aching) and perceived to originate in the abdomen. Evidence: TAS. Frequency: Very rare (HP:0040284). (ORPHA:563)
- Asthma (HP:0002099): Asthma is characterized by increased responsiveness of the tracheobronchial tree to multiple stimuli, leading to narrowing of the air passages with resultant dyspnea, cough, and wheezing. Evidence: TAS. Frequency: Very rare (HP:0040284). (ORPHA:563)
- Stroke-like episode (HP:0002401): No consensus exists on what a stroke-like episode is, but these episodes can be functionally defined as a new neurological deficit, occurring with or without the context of seizures, which last longer than 24 hours. Evidence: TAS. Frequency: Very rare (HP:0040284). (ORPHA:563)
- Respiratory failure (HP:0002878): A severe form of respiratory insufficiency characterized by inadequate gas exchange such that the levels of oxygen or carbon dioxide cannot be maintained within normal limits. Evidence: TAS. Frequency: Very rare (HP:0040284). (ORPHA:563)
- Abnormality of thyroid physiology (HP:0002926): An abnormal functionality of the thyroid gland. Evidence: TAS. Frequency: Very rare (HP:0040284). (ORPHA:563)
- Autoimmunity (HP:0002960): The occurrence of an immune reaction against the organism's own cells or tissues. Evidence: TAS. Frequency: Very rare (HP:0040284). (ORPHA:563)
- Left bundle branch block (HP:0011713): A conduction block of the left branch of the bundle of His. This manifests as a generalized disturbance of QRS morphology on EKG. Evidence: TAS. Frequency: Very rare (HP:0040284). (ORPHA:563)
- Cardiogenic shock (HP:0030149): Severely decreased cardiac output with evidence of inadequate end-organ perfusion (i.e., tissue hypoxia) in the presence of adequate intravascular volume. Evidence: TAS. Frequency: Very rare (HP:0040284). (ORPHA:563)
These phenotypes are associated with the disease Peripartum cardiomyopathy (ORPHA:563).